Phenotypes associated with the disease Phenylketonuria (ORPHA:716):
- Phenylalaninuria (HP:0032351): Increased level of phenylalanine in urine. Evidence: TAS. Frequency: Very frequent (HP:0040281). (ORPHA:716)
- Microcephaly (HP:0000252): Head circumference below 2 standard deviations below the mean for age and gender. Evidence: TAS. Frequency: Frequent (HP:0040282). (ORPHA:716)
- Atypical behavior (HP:0000708): Atypical behavior is an abnormality in a person's actions that can be controlled or modulated by the will of the individual. While abnormal behaviors can be difficult to control, they are distinct from other abnormal actions that cannot be affected by the individual's will. Evidence: TAS. Frequency: Frequent (HP:0040282). (ORPHA:716)
- Osteopenia (HP:0000938): Osteopenia is a term to define bone density that is not normal but also not as low as osteoporosis. By definition from the World Health Organization osteopenia is defined by bone densitometry as a T score -1 to -2.5. Evidence: TAS. Frequency: Frequent (HP:0040282). (ORPHA:716)
- Eczematoid dermatitis (HP:0000964): Eczema is a form of dermatitis that is characterized by scaly, pruritic, erythematous lesions located on flexural surfaces. Evidence: TAS. Frequency: Frequent (HP:0040282). (ORPHA:716)
- Hypopigmentation of the skin (HP:0001010): A reduction of skin color related to a decrease in melanin production and deposition. Evidence: TAS. Frequency: Frequent (HP:0040282). (ORPHA:716)
- Seizure (HP:0001250): A seizure is an intermittent abnormality of nervous system physiology characterized by a transient occurrence of signs and/or symptoms due to abnormal excessive or synchronous neuronal activity in the brain. Evidence: TAS. Frequency: Frequent (HP:0040282). (ORPHA:716)
- Global developmental delay (HP:0001263): A delay in the achievement of motor or mental milestones in the domains of development of a child, including motor skills, speech and language, cognitive skills, and social and emotional skills. This term should only be used to describe children younger than five years of age. Evidence: TAS. Frequency: Frequent (HP:0040282). (ORPHA:716)
- Specific learning disability (HP:0001328): Impairment of certain skills such as reading or writing, coordination, self-control, or attention that interfere with the ability to learn. The impairment is not related to a global deficiency of intelligence. Evidence: TAS. Frequency: Frequent (HP:0040282). (ORPHA:716)
- Growth delay (HP:0001510): A deficiency or slowing down of growth pre- and postnatally. Evidence: TAS. Frequency: Frequent (HP:0040282). (ORPHA:716)
- EEG abnormality (HP:0002353): Abnormality observed by electroencephalogram (EEG), which is used to record of the brain's spontaneous electrical activity from multiple electrodes placed on the scalp. Evidence: TAS. Frequency: Frequent (HP:0040282). (ORPHA:716)
- Abnormal cerebral white matter morphology (HP:0002500): An abnormality of the cerebral white matter. Evidence: TAS. Frequency: Frequent (HP:0040282). (ORPHA:716)
- Hyperphenylalaninemia (HP:0004923): The concentration of L-phenylalanine in the blood circulation is above the upper limit of normal. Evidence: TAS. Frequency: Frequent (HP:0040282). (ORPHA:716)
- Severe intellectual disability (HP:0010864): Severe intellectual disability (ID) is defined as a type of ID characterized by severely sub-average adaptive functioning and intellectual functioning, with an intelligence quotient (IQ) the range of 20-34. Evidence: TAS. Frequency: Frequent (HP:0040282). (ORPHA:716)
- Musty odor (HP:0410021): Pungent body odor. Evidence: TAS. Frequency: Frequent (HP:0040282). (ORPHA:716)
- Depression (HP:0000716): Frequently experiencing feelings of being down, miserable, and/or hopeless; struggling to recover from these moods; having a pessimistic outlook on the future; feeling a pervasive sense of shame; having a low self-worth; experiencing thoughts of suicide and engaging in suicidal behavior. Evidence: TAS. Frequency: Occasional (HP:0040283). (ORPHA:716)
- Dementia (HP:0000726): A loss of global cognitive ability of sufficient amount to interfere with normal social or occupational function. Dementia represents a loss of previously present cognitive abilities, generally in adults, and can affect memory, thinking, language, judgment, and behavior. Evidence: TAS. Frequency: Occasional (HP:0040283). (ORPHA:716)
- Short attention span (HP:0000736): Reduced attention span characterized by distractibility and impulsivity. Evidence: TAS. Frequency: Occasional (HP:0040283). (ORPHA:716)
- Anxiety (HP:0000739): Intense feelings of nervousness, tension, or panic often arise in response to interpersonal stresses. There is worry about the negative effects of past unpleasant experiences and future negative possibilities. Individuals may feel fearful, apprehensive, or threatened by uncertainty, and they may also have fears of falling apart or losing control. Evidence: TAS. Frequency: Occasional (HP:0040283). (ORPHA:716)
- Ataxia (HP:0001251): Ataxia refers to impaired coordination of voluntary muscle movement. Cerebellar ataxia refers to ataxia due to dysfunction of the cerebellum. This causes a variety of elementary neurological deficits including asynergy (lack of coordination between muscles, limbs and joints), dysmetria (lack of ability to judge distances that can lead to under- or overshoot in grasping movements), and dysdiadochokinesia (inability to perform rapid movements requiring antagonizing muscle groups to be switched on and off repeatedly). Evidence: TAS. Frequency: Occasional (HP:0040283). (ORPHA:716)
- Encephalopathy (HP:0001298): Encephalopathy is a term that means brain disease, damage, or malfunction. In general, encephalopathy is manifested by an altered mental state. Evidence: TAS. Frequency: Occasional (HP:0040283). (ORPHA:716)
- Tremor (HP:0001337): An unintentional, oscillating to-and-fro muscle movement about a joint axis. Evidence: TAS. Frequency: Occasional (HP:0040283). (ORPHA:716)
- Lower limb spasticity (HP:0002061): Spasticity (velocity-dependent increase in tonic stretch reflexes with increased muscle tone and hyperexcitable tendon reflexes) in the muscles of the lower limbs, hips, and pelvis. Evidence: TAS. Frequency: Occasional (HP:0040283). (ORPHA:716)
- Abnormal cardiovascular system morphology (HP:0030680): Any structural anomaly of the heart and blood vessels. Evidence: TAS. Frequency: Occasional (HP:0040283). (ORPHA:716)
- Cerebral visual impairment (HP:0100704): A form of loss of vision caused by damage to the visual cortex rather than a defect in the eye. Evidence: TAS. Frequency: Occasional (HP:0040283). (ORPHA:716)